- Protanomaly (HP:0200018): A type of anomalous trichromacy associated with defective long-wavelength-sensitive (L) cones, causing the sensitivity spectrum to be shifted toward medium wavelengths. This leads to difficulties especially in distinguishing red and green. Evidence: PCS. (OMIM:303900)
- X-linked recessive inheritance (HP:0001419): A mode of inheritance that is observed for recessive traits related to a gene encoded on the X chromosome. In the context of medical genetics, X-linked recessive disorders manifest in males (who have one copy of the X chromosome and are thus hemizygotes), but generally not in female heterozygotes who have one mutant and one normal allele. Evidence: PCS. (OMIM:303900)
These phenotypes are associated with the disease red color blindness (OMIM:303900).